- Congenital onset (HP:0003577): A phenotypic abnormality that is present at birth. Evidence: PCS. Frequency: 3/3. (PMID:30642273)
- Onychauxis (HP:0012542): Thickened nails without deformity. Evidence: PCS. Frequency: 3/3. (PMID:30642273)
- Nail dysplasia (HP:0002164): The presence of developmental dysplasia of the nail. Evidence: PCS. Frequency: 3/3. (PMID:30642273)
- Onychogryphosis (HP:0001805): Onychogryphosis is a disorder of nail plate growth that is clinically characterized by an opaque, yellow-brown thickening of the nail plate with associated gross hyperkeratosis, elongation, and increased curvature. Evidence: TAS. Frequency: Occasional (HP:0040283). (OMIM:161050)
- Onycholysis (HP:0001806): Detachment of the nail from the nail bed. Evidence: PCS. Frequency: 3/3. (PMID:30642273)
- Autosomal recessive inheritance (HP:0000007): A mode of inheritance that is observed for traits related to a gene encoded on one of the autosomes (i.e., the human chromosomes 1-22) in which a trait manifests in individuals with two pathogenic alleles, either homozygotes (two copies of the same mutant allele) or compound heterozygotes (whereby each copy of a gene has a distinct mutant allele). Evidence: PCS. (PMID:23374899)
- Trachyonychia (HP:0030804): Excessive longitudinal ridging that gives the surface of the nail plate a rough appearance. It results from multiple foci of defective keratinization of the proximal nail matrix. Evidence: IEA. (OMIM:161050)
- Slowly progressive (HP:0003677): Applies to a disease manifestation that only slowly increases in scope or severity over the course of time. Evidence: TAS. (OMIM:161050)
These phenotypes are associated with the disease nonsyndromic congenital nail disorder 1 (OMIM:161050).